Phenotypes associated with the disease Severe growth deficiency-strabismus-extensive dermal melanocytosis-intellectual disability syndrome (ORPHA:488627):
- Coarse facial features (HP:0000280): Absence of fine and sharp appearance of brows, nose, lips, mouth, and chin, usually because of rounded and heavy features or thickened skin with or without thickening of subcutaneous and bony tissues. Evidence: TAS. Frequency: Very frequent (HP:0040281). (ORPHA:488627)
- Seizure (HP:0001250): A seizure is an intermittent abnormality of nervous system physiology characterized by a transient occurrence of signs and/or symptoms due to abnormal excessive or synchronous neuronal activity in the brain. Evidence: TAS. Frequency: Very frequent (HP:0040281). (ORPHA:488627)
- Global developmental delay (HP:0001263): A delay in the achievement of motor or mental milestones in the domains of development of a child, including motor skills, speech and language, cognitive skills, and social and emotional skills. This term should only be used to describe children younger than five years of age. Evidence: TAS. Frequency: Very frequent (HP:0040281). (ORPHA:488627)
- Failure to thrive in infancy (HP:0001531). Evidence: TAS. Frequency: Very frequent (HP:0040281). (ORPHA:488627)
- Proteinuria (HP:0000093): Increased levels of protein in the urine. Evidence: TAS. Frequency: Frequent (HP:0040282). (ORPHA:488627)
- Progressive microcephaly (HP:0000253): Progressive microcephaly is diagnosed when the head circumference falls progressively behind age- and gender-dependent norms. Evidence: TAS. Frequency: Frequent (HP:0040282). (ORPHA:488627)
- Gait disturbance (HP:0001288): The term gait disturbance can refer to any disruption of the ability to walk. Evidence: TAS. Frequency: Frequent (HP:0040282). (ORPHA:488627)
- Cerebral cortical atrophy (HP:0002120): Atrophy of the cortex of the cerebrum. Evidence: TAS. Frequency: Frequent (HP:0040282). (ORPHA:488627)
- Profound intellectual disability (HP:0002187): Profound intellectual disability (ID) is defined as a type of ID characterized by profoundly sub-average adaptive functioning and intellectual functioning, with an intelligence quotient (IQ) below 20. Evidence: TAS. Frequency: Frequent (HP:0040282). (ORPHA:488627)
- Poor speech (HP:0002465). Evidence: TAS. Frequency: Frequent (HP:0040282). (ORPHA:488627)
- Multifocal cerebral white matter abnormalities (HP:0007052). Evidence: TAS. Frequency: Frequent (HP:0040282). (ORPHA:488627)
- Bilateral tonic-clonic seizure with focal onset (HP:0007334): A bilateral tonic-clonic seizure with focal onset is a focal-onset seizure which progresses into a bilateral tonic-clonic phase. Evidence: TAS. Frequency: Frequent (HP:0040282). (ORPHA:488627)
- Decreased glomerular filtration rate (HP:0012213): An abnormal reduction in the volume of fluid filtered out of plasma through glomerular capillary walls into Bowman's capsules per unit of time. Evidence: TAS. Frequency: Frequent (HP:0040282). (ORPHA:488627)
- Chronic kidney disease (HP:0012622): Functional anomaly of the kidney persisting for at least three months. Evidence: TAS. Frequency: Frequent (HP:0040282). (ORPHA:488627)
- Nephrotic syndrome (HP:0000100): Nephrotic syndrome is a collection of findings resulting from glomerular dysfunction with an increase in glomerular capillary wall permeability associated with pronounced proteinuria. Nephrotic syndrome refers to the constellation of clinical findings that result from severe renal loss of protein, with Proteinuria and hypoalbuminemia, edema, and hyperlipidemia. Evidence: TAS. Frequency: Occasional (HP:0040283). (ORPHA:488627)
- Sensorineural hearing impairment (HP:0000407): A type of hearing impairment in one or both ears related to an abnormal functionality of the cochlear nerve. Evidence: TAS. Frequency: Occasional (HP:0040283). (ORPHA:488627)
- Strabismus (HP:0000486): A misalignment of the eyes so that the visual axes deviate from bifoveal fixation. The classification of strabismus may be based on a number of features including the relative position of the eyes, whether the deviation is latent or manifest, intermittent or constant, concomitant or otherwise and according to the age of onset and the relevance of any associated refractive error. Evidence: TAS. Frequency: Occasional (HP:0040283). (ORPHA:488627)
- Visual impairment (HP:0000505): Visual impairment (or vision impairment) is vision loss (of a person) to such a degree as to qualify as an additional support need through a significant limitation of visual capability resulting from either disease, trauma, or congenital or degenerative conditions that cannot be corrected by conventional means, such as refractive correction, medication, or surgery. Evidence: TAS. Frequency: Occasional (HP:0040283). (ORPHA:488627)
- Blue sclerae (HP:0000592): An abnormal bluish coloration of the sclera. Evidence: TAS. Frequency: Occasional (HP:0040283). (ORPHA:488627)
- Nystagmus (HP:0000639): Rhythmic, involuntary oscillations of one or both eyes related to abnormality in fixation, conjugate gaze, or vestibular mechanisms. Evidence: TAS. Frequency: Occasional (HP:0040283). (ORPHA:488627)
- Psychosis (HP:0000709): A condition characterized by changes in personality and thought patterns, often accompanied by hallucinations and delusional beliefs, is known as psychosis. Evidence: TAS. Frequency: Occasional (HP:0040283). (ORPHA:488627)
- Aggressive behavior (HP:0000718): Behavior or an act aimed at harming a person, animal, or physical property (e.g., acts of physical violence; shouting, swearing, and using harsh language; slashing someone's tires). Evidence: TAS. Frequency: Occasional (HP:0040283). (ORPHA:488627)
- Cyanosis (HP:0000961): Bluish discoloration of the skin and mucosa due to poor circulation or inadequate oxygenation of arterial or capillary blood. Evidence: TAS. Frequency: Occasional (HP:0040283). (ORPHA:488627)
- Dysarthria (HP:0001260): Dysarthric speech is a general description referring to a neurological speech disorder characterized by poor articulation. Depending on the involved neurological structures, dysarthria may be further classified as spastic, flaccid, ataxic, hyperkinetic and hypokinetic, or mixed. Evidence: TAS. Frequency: Occasional (HP:0040283). (ORPHA:488627)
- Generalized hypotonia (HP:0001290): Generalized muscular hypotonia (abnormally low muscle tone). Evidence: TAS. Frequency: Occasional (HP:0040283). (ORPHA:488627)
- Absent speech (HP:0001344): Complete lack of development of speech and language abilities. Evidence: TAS. Frequency: Occasional (HP:0040283). (ORPHA:488627)
- Hyperreflexia (HP:0001347): Hyperreflexia is the presence of hyperactive stretch reflexes of the muscles. Evidence: TAS. Frequency: Occasional (HP:0040283). (ORPHA:488627)
- Tubulointerstitial nephritis (HP:0001970): A form of inflammation of the kidney affecting the interstitium of the kidneys surrounding the tubules. Evidence: TAS. Frequency: Occasional (HP:0040283). (ORPHA:488627)
- Dysphagia (HP:0002015): Difficulty in swallowing. Evidence: TAS. Frequency: Occasional (HP:0040283). (ORPHA:488627)
- Hypoplasia of the corpus callosum (HP:0002079): Underdevelopment of the corpus callosum. Evidence: TAS. Frequency: Occasional (HP:0040283). (ORPHA:488627)
- Ventriculomegaly (HP:0002119): An increase in size of the ventricular system of the brain. Evidence: TAS. Frequency: Occasional (HP:0040283). (ORPHA:488627)
- Gait imbalance (HP:0002141). Evidence: TAS. Frequency: Occasional (HP:0040283). (ORPHA:488627)
- Pseudobulbar affect (HP:0002193): Pseudobulbar affect (PBA) is characterized by uncontrolled crying or laughing which may be disproportionate or inappropriate to the social context. Thus, there is a disparity between the patient's emotional expression and his or her emotional experience. Evidence: TAS. Frequency: Occasional (HP:0040283). (ORPHA:488627)
- Visual hallucination (HP:0002367): Visual perception in the absence of a visual stimulus. Evidence: TAS. Frequency: Occasional (HP:0040283). (ORPHA:488627)
- Genu valgum (HP:0002857): The legs angle inward, such that the knees are close together and the ankles far apart. Evidence: TAS. Frequency: Occasional (HP:0040283). (ORPHA:488627)
- Lateral ventricle dilatation (HP:0006956). Evidence: TAS. Frequency: Occasional (HP:0040283). (ORPHA:488627)
- Dysplastic corpus callosum (HP:0006989): Dysplasia and dysgenesis of the corpus callosum are nonspecific descriptions that imply defective development of the corpus callosum. The term dysplasia is applied when the morphology of the corpus callosum is altered as a congenital trait. For instance, the corpus callosum may be hump-shaped, kinked, or a striped corpus callosum that lacks an anatomically distinct genu and splenium. Evidence: TAS. Frequency: Occasional (HP:0040283). (ORPHA:488627)
- Multifocal hyperintensity of cerebral white matter on MRI (HP:0040329): An abnormal area of increased brightness (hyperintensity) that occurs in several distinct areas. Evidence: TAS. Frequency: Occasional (HP:0040283). (ORPHA:488627)
- Arachnoid cyst (HP:0100702): An extra-parenchymal and intra-arachnoidal collection of fluid with a composition similar to that of cerebrospinal fluid. Evidence: TAS. Frequency: Occasional (HP:0040283). (ORPHA:488627)
- Blue nevus (HP:0100814): A solitary, bluish, smooth surfaced macule, papule or plaque that is generally round or oval in shape. The histopathology of blue nevi varies by subtype, but general characteristics include a vertical wedge or bulbous shaped proliferation of spindle cells, dendritic melanocytes, and melanophages into a sclerotic dermis or subcutis. Evidence: TAS. Frequency: Occasional (HP:0040283). (ORPHA:488627)